Phenotypes associated with the disease prostate cancer, hereditary, 1 (OMIM:601518):
- Adult onset (HP:0003581): Onset of disease manifestations in adulthood, defined here as at the age of 16 years or later. Evidence: PCS. Frequency: 11/11. (PMID:11799394)
- Prostate cancer (HP:0012125): A cancer of the prostate. Evidence: PCS. Frequency: 11/11. (PMID:11799394)
- Autosomal dominant inheritance (HP:0000006): A mode of inheritance that is observed for traits related to a gene encoded on one of the autosomes (i.e., the human chromosomes 1-22) in which a trait manifests in heterozygotes. In the context of medical genetics, an autosomal dominant disorder is caused when a single copy of the mutant allele is present. Males and females are affected equally, and can both transmit the disorder with a risk of 50% for each child of inheriting the mutant allele. Evidence: PCS. (PMID:11799394)